Phenotypes associated with the disease polydactyly-myopia syndrome (OMIM:174310):
- Postaxial hand polydactyly (HP:0001162): Supernumerary digits located at the ulnar side of the hand (that is, on the side with the fifth finger). Evidence: IEA. (OMIM:174310)
- Autosomal dominant inheritance (HP:0000006): A mode of inheritance that is observed for traits related to a gene encoded on one of the autosomes (i.e., the human chromosomes 1-22) in which a trait manifests in heterozygotes. In the context of medical genetics, an autosomal dominant disorder is caused when a single copy of the mutant allele is present. Males and females are affected equally, and can both transmit the disorder with a risk of 50% for each child of inheriting the mutant allele. Evidence: IEA. (OMIM:174310)
- Myopia (HP:0000545): An abnormality of refraction characterized by the ability to see objects nearby clearly, while objects in the distance appear blurry. Evidence: IEA. (OMIM:174310)